Phenotypes associated with the disease panic disorder 1 (OMIM:167870):
- Anxiety (HP:0000739): Intense feelings of nervousness, tension, or panic often arise in response to interpersonal stresses. There is worry about the negative effects of past unpleasant experiences and future negative possibilities. Individuals may feel fearful, apprehensive, or threatened by uncertainty, and they may also have fears of falling apart or losing control. Evidence: IEA. (OMIM:167870)
- Autosomal dominant inheritance (HP:0000006): A mode of inheritance that is observed for traits related to a gene encoded on one of the autosomes (i.e., the human chromosomes 1-22) in which a trait manifests in heterozygotes. In the context of medical genetics, an autosomal dominant disorder is caused when a single copy of the mutant allele is present. Males and females are affected equally, and can both transmit the disorder with a risk of 50% for each child of inheriting the mutant allele. Evidence: TAS. (OMIM:167870)